Phenotypes associated with the disease TWINNING DUE TO SUPERFETATION (OMIM:191250):
- Autosomal dominant inheritance (HP:0000006): A mode of inheritance that is observed for traits related to a gene encoded on one of the autosomes (i.e., the human chromosomes 1-22) in which a trait manifests in heterozygotes. In the context of medical genetics, an autosomal dominant disorder is caused when a single copy of the mutant allele is present. Males and females are affected equally, and can both transmit the disorder with a risk of 50% for each child of inheriting the mutant allele. Evidence: IEA. (OMIM:191250)